Phenotypes associated with the disease TOOTH SIZE (OMIM:314240):
- Abnormality of the dentition (HP:0000164): Any abnormality of the teeth. Evidence: IEA. (OMIM:314240)
- X-linked inheritance (HP:0001417): A mode of inheritance that is observed for traits related to a gene encoded on the X chromosome. Evidence: IEA. (OMIM:314240)